- Torticollis (HP:0000473): Involuntary contractions of the neck musculature resulting in an abnormal posture of or abnormal movements of the head. Evidence: TAS. (OMIM:614588)
- Young adult onset (HP:0011462): Onset of disease at the age of between 16 and 40 years. Evidence: TAS. (OMIM:614588)
- Laryngeal dystonia (HP:0012049): A form of focal dystonia that affects the vocal cords, associated with involuntary contractions of the vocal cords causing interruptions of speech and affecting the voice quality and often leading to patterned, repeated breaks in speech. Evidence: TAS. (OMIM:614588)
- Autosomal dominant inheritance (HP:0000006): A mode of inheritance that is observed for traits related to a gene encoded on one of the autosomes (i.e., the human chromosomes 1-22) in which a trait manifests in heterozygotes. In the context of medical genetics, an autosomal dominant disorder is caused when a single copy of the mutant allele is present. Males and females are affected equally, and can both transmit the disorder with a risk of 50% for each child of inheriting the mutant allele. Evidence: TAS. (OMIM:614588)
- Blepharospasm (HP:0000643): A focal dystonia that affects the muscles of the eyelids and brow, associated with involuntary recurrent spasm of both eyelids. Evidence: TAS. (OMIM:614588)
These phenotypes are associated with the disease dystonia 21 (OMIM:614588).